Phenotypes associated with the disease lymphatic malformation 8 (OMIM:618773):
- Polyhydramnios (HP:0001561): The presence of excess amniotic fluid in the uterus during pregnancy. Evidence: PCS. Frequency: 2/2. Onset: Fetal onset (HP:0011461). (PMID:30115739)
- Pleural effusion (HP:0002202): The presence of an excessive amount of fluid in the pleural cavity. Evidence: PCS. Onset: Fetal onset (HP:0011461). (PMID:30115739)
- Nonimmune hydrops fetalis (HP:0001790): A type of hydrops fetalis in which there is no identifiable circulating antibody to red blood cell antigens . Evidence: PCS. Frequency: 2/2. Onset: Fetal onset (HP:0011461). (PMID:30115739)
- Generalized edema (HP:0007430): Generalized abnormal accumulation of fluid beneath the skin, or in one or more cavities of the body. Evidence: PCS. (PMID:30115739)
- Stillbirth (HP:0003826): Death of the fetus in utero after at least 22 weeks of gestation. Evidence: PCS. (PMID:30115739)
- Autosomal recessive inheritance (HP:0000007): A mode of inheritance that is observed for traits related to a gene encoded on one of the autosomes (i.e., the human chromosomes 1-22) in which a trait manifests in individuals with two pathogenic alleles, either homozygotes (two copies of the same mutant allele) or compound heterozygotes (whereby each copy of a gene has a distinct mutant allele). Evidence: PCS. (PMID:30115739)
- Pericardial effusion (HP:0001698): Accumulation of fluid within the pericardium. Evidence: PCS. Onset: Fetal onset (HP:0011461). (PMID:30115739)